- Hypertonia (HP:0001276): A condition in which there is increased muscle tone so that arms or legs, for example, are stiff and difficult to move. Evidence: PCS. Frequency: 1/5. Onset: Neonatal onset (HP:0003623). (PMID:28475857)
- Astigmatism (HP:0000483): A type of refraction error associated with abnormal curvatures on the anterior and/or posterior surface of the cornea. Evidence: PCS. Frequency: 1/5. (PMID:28475857)
- Congenital onset (HP:0003577): A phenotypic abnormality that is present at birth. Evidence: PCS. Frequency: 1/5. (PMID:28475857)
- Strabismus (HP:0000486): A misalignment of the eyes so that the visual axes deviate from bifoveal fixation. The classification of strabismus may be based on a number of features including the relative position of the eyes, whether the deviation is latent or manifest, intermittent or constant, concomitant or otherwise and according to the age of onset and the relevance of any associated refractive error. Evidence: PCS. Frequency: 1/5. (PMID:28475857)
- Thin corpus callosum (HP:0033725): An abnormally thin corpus callous, due to atrophy, hypoplasia or agenesis. This term is intended to be used in situations where it is not known if thinning of the corpus callosum (for instance, as visualized by magnetic resonance tomography) is due to abnormal development (e.g. a leukodystrophy) or atrophy following normal development (e.g. neurodegeneration). Evidence: PCS. Frequency: 1/5. (PMID:28475857)
- Chronic constipation (HP:0012450): Constipation for longer than three months with fewer than 3 bowel movements per week, straining, lumpy or hard stools, and a sensation of anorectal obstruction or incomplete defecation. Evidence: PCS. Frequency: 1/5. (PMID:28475857)
- Anxiety (HP:0000739): Intense feelings of nervousness, tension, or panic often arise in response to interpersonal stresses. There is worry about the negative effects of past unpleasant experiences and future negative possibilities. Individuals may feel fearful, apprehensive, or threatened by uncertainty, and they may also have fears of falling apart or losing control. Evidence: PCS. Frequency: 1/5. (PMID:28475857)
- Ventriculomegaly (HP:0002119): An increase in size of the ventricular system of the brain. Evidence: PCS. Frequency: 1/5. (PMID:28475857)
- Macrocephaly (HP:0000256): Occipitofrontal (head) circumference greater than 97th centile compared to appropriate, age matched, sex-matched normal standards. Alternatively, a apparently increased size of the cranium. Evidence: PCS. (PMID:28475857)
- Intellectual disability (HP:0001249): The term intellectual disability or intellectual developmental disorder is used to describe significantly sub-average intellectual and adaptive functioning based on clinical assessment and as measured by individually administered, appropriately normed, standardized and validated tests of intellectual functioning and adaptive behavior, with onset during the developmental period from infancy through adolescence. Evidence: PCS. Frequency: 4/4. (PMID:28475857)
- Neonatal onset (HP:0003623): Onset of signs or symptoms of disease within the first 28 days of life. Evidence: PCS. Frequency: 4/5. (PMID:28475857)
- Kyphoscoliosis (HP:0002751): An abnormal curvature of the spine in both a coronal (lateral) and sagittal (back-to-front) plane. Evidence: PCS. Frequency: 1/5. (PMID:28475857)
- Nevus (HP:0003764): A nevus is a type of hamartoma that is a circumscribed stable malformation of the skin. Evidence: PCS. Frequency: 1/5. (PMID:28475857)
- Talipes equinovarus (HP:0001762): Talipes equinovarus (also called clubfoot) typically has four main components: inversion and adduction of the forefoot; inversion of the heel and hindfoot; equinus (limitation of extension) of the ankle and subtalar joint; and internal rotation of the leg. Evidence: PCS. Frequency: 1/5. (PMID:28475857)
- Full cheeks (HP:0000293): Increased prominence or roundness of soft tissues between zygomata and mandible. Evidence: PCS. Frequency: 5/5. (PMID:28475857)
- Feeding difficulties (HP:0011968): Impaired ability to eat related to problems gathering food and getting ready to suck, chew, or swallow it. Evidence: PCS. Frequency: 2/5. (PMID:28475857)
- Redundant skin (HP:0001582): Loose and sagging skin often associated with loss of skin elasticity. Evidence: PCS. Frequency: 1/5. (PMID:28475857)
- Global developmental delay (HP:0001263): A delay in the achievement of motor or mental milestones in the domains of development of a child, including motor skills, speech and language, cognitive skills, and social and emotional skills. This term should only be used to describe children younger than five years of age. Evidence: PCS. Frequency: 5/5. (PMID:28475857)
- Camptodactyly (HP:0012385): The distal interphalangeal joint and/or the proximal interphalangeal joint of the fingers or toes cannot be extended to 180 degrees by either active or passive extension. Evidence: PCS. Frequency: 1/5. (PMID:28475857)
- High anterior hairline (HP:0009890): Distance between the hairline (trichion) and the glabella (the most prominent point on the frontal bone above the root of the nose), in the midline, more than two SD above the mean. Alternatively, an apparently increased distance between the hairline and the glabella. Evidence: PCS. Frequency: 5/5. (PMID:28475857)
- Telecanthus (HP:0000506): Distance between the inner canthi more than two standard deviations above the mean (objective); or, apparently increased distance between the inner canthi. Evidence: PCS. Frequency: 5/5. (PMID:28475857)
- Amblyopia (HP:0000646): Reduced visual acuity that is uncorrectable by lenses in the absence of detectable anatomic defects in the eye or visual pathways. Evidence: PCS. Frequency: 1/5. (PMID:28475857)
- Neonatal hypotonia (HP:0001319): Muscular hypotonia (abnormally low muscle tone) manifesting in the neonatal period. Evidence: PCS. Frequency: 2/5. Onset: Neonatal onset (HP:0003623). (PMID:28475857)
- Accelerated skeletal maturation (HP:0005616): An abnormally increased rate of skeletal maturation. Accelerated skeletal maturation can be diagnosed on the basis of an estimation of the bone age from radiographs of specific bones in the human body. Evidence: PCS. Frequency: 1/5. (PMID:28475857)
- Cryptorchidism (HP:0000028): Testis in inguinal canal. That is, absence of one or both testes from the scrotum owing to failure of the testis or testes to descend through the inguinal canal to the scrotum. Evidence: PCS. Frequency: 1/5. (PMID:28475857)
- Autosomal dominant inheritance (HP:0000006): A mode of inheritance that is observed for traits related to a gene encoded on one of the autosomes (i.e., the human chromosomes 1-22) in which a trait manifests in heterozygotes. In the context of medical genetics, an autosomal dominant disorder is caused when a single copy of the mutant allele is present. Males and females are affected equally, and can both transmit the disorder with a risk of 50% for each child of inheriting the mutant allele. Evidence: PCS. (PMID:28475857)
These phenotypes are associated with the disease Rahman syndrome (OMIM:617537).